Phenotypes associated with the disease spinocerebellar atrophy with pupillary paralysis (OMIM:183100):
- Spinocerebellar atrophy (HP:0007263): Atrophy affecting the cerebellum and the spinocerebellar tracts of the spinal cord. Evidence: IEA. (OMIM:183100)
- Autosomal dominant inheritance (HP:0000006): A mode of inheritance that is observed for traits related to a gene encoded on one of the autosomes (i.e., the human chromosomes 1-22) in which a trait manifests in heterozygotes. In the context of medical genetics, an autosomal dominant disorder is caused when a single copy of the mutant allele is present. Males and females are affected equally, and can both transmit the disorder with a risk of 50% for each child of inheriting the mutant allele. Evidence: IEA. (OMIM:183100)